- Dry skin (HP:0000958): Skin characterized by the lack of natural or normal moisture. Evidence: TAS. Frequency: Very frequent (HP:0040281). (ORPHA:248)
- Abnormal fingernail morphology (HP:0001231): An abnormality of the fingernails. Evidence: TAS. Frequency: Very frequent (HP:0040281). (ORPHA:248)
- Fine hair (HP:0002213): Hair that is fine or thin to the touch. Evidence: TAS. Frequency: Very frequent (HP:0040281). (ORPHA:248)
- Premature loss of primary teeth (HP:0006323): Loss of the primary (also known as deciduous) teeth before the usual age. Evidence: TAS. Frequency: Very frequent (HP:0040281). (ORPHA:248)
- Abnormal toenail morphology (HP:0008388): An anomaly of the toenail. Evidence: TAS. Frequency: Very frequent (HP:0040281). (ORPHA:248)
- Hypoplasia of teeth (HP:0000685): Developmental hypoplasia of teeth. Evidence: TAS. Frequency: Very frequent (HP:0040281). (ORPHA:248)
- Hypohidrosis (HP:0000966): Abnormally diminished capacity to sweat. Evidence: TAS. Frequency: Frequent (HP:0040282). (ORPHA:248)
- Abnormal hair morphology (HP:0001595): An abnormality of the hair. Evidence: TAS. Frequency: Very frequent (HP:0040281). (ORPHA:248)
- Alopecia (HP:0001596): A noncongenital process of hair loss, which may progress to partial or complete baldness. Evidence: TAS. Frequency: Frequent (HP:0040282). (ORPHA:248)
- Abnormal dental morphology (HP:0006482): An abnormality of the morphology of the tooth. Evidence: TAS. Frequency: Frequent (HP:0040282). (ORPHA:248)
These phenotypes are associated with the disease Autosomal recessive hypohidrotic ectodermal dysplasia (ORPHA:248).